Phenotypes associated with the disease Sheehan syndrome (ORPHA:91355):
- Dyspareunia (HP:0030016): Recurrent or persistent genital pain associated with sexual intercourse. Evidence: TAS. Frequency: Frequent (HP:0040282). (ORPHA:91355)
- Decreased female libido (HP:0030018): Diminished sexual desire in female. Evidence: TAS. Frequency: Frequent (HP:0040282). (ORPHA:91355)
- Sensorineural hearing impairment (HP:0000407): A type of hearing impairment in one or both ears related to an abnormal functionality of the cochlear nerve. Evidence: TAS. Frequency: Occasional (HP:0040283). (ORPHA:91355)
- Diplopia (HP:0000651): Diplopia is a condition in which a single object is perceived as two images, it is also known as double vision. Evidence: TAS. Frequency: Occasional (HP:0040283). (ORPHA:91355)
- Hashimoto thyroiditis (HP:0000872): A chronic, autoimmune type of thyroiditis associated with hypothyroidism. Evidence: TAS. Frequency: Occasional (HP:0040283). (ORPHA:91355)
- Muscle weakness (HP:0001324): Reduced strength of muscles. Evidence: TAS. Frequency: Occasional (HP:0040283). (ORPHA:91355)
- Obesity (HP:0001513): Accumulation of substantial excess body fat. Evidence: TAS. Frequency: Occasional (HP:0040283). (ORPHA:91355)
- Bradycardia (HP:0001662): A slower than normal heart rate (in adults, slower than 60 beats per minute). Evidence: TAS. Frequency: Occasional (HP:0040283). (ORPHA:91355)
- Palpitations (HP:0001962): A sensation that the heart is pounding or racing, which is a non-specific sign but may be a manifestation of arrhythmia. Evidence: TAS. Frequency: Occasional (HP:0040283). (ORPHA:91355)
- Constipation (HP:0002019): Infrequent or difficult evacuation of feces. Evidence: TAS. Frequency: Occasional (HP:0040283). (ORPHA:91355)
- Vertigo (HP:0002321): An abnormal sensation of spinning while the body is actually stationary. Evidence: TAS. Frequency: Occasional (HP:0040283). (ORPHA:91355)
- Arthralgia (HP:0002829): Joint pain. Evidence: TAS. Frequency: Occasional (HP:0040283). (ORPHA:91355)
- Hyponatremia (HP:0002902): The concentration of sodium in the blood circulation is below the lower limit of normal. Evidence: TAS. Frequency: Occasional (HP:0040283). (ORPHA:91355)
- Antinuclear antibody positivity (HP:0003493): The presence of autoantibodies in the serum that react against nuclei or nuclear components. Evidence: TAS. Frequency: Occasional (HP:0040283). (ORPHA:91355)
- Poor appetite (HP:0004396): A reduced desire to eat. Evidence: TAS. Frequency: Occasional (HP:0040283). (ORPHA:91355)
- Chronic lymphocytic meningitis (HP:0007041): Meningitis that persists for more than 4 weeks, and lymphocytes are present in the cerebrospinal fluid (CSF). Evidence: TAS. Frequency: Occasional (HP:0040283). (ORPHA:91355)
- Chills (HP:0025143): A sudden sensation of feeling cold. Evidence: TAS. Frequency: Occasional (HP:0040283). (ORPHA:91355)
- Thunderclap headache (HP:0030907): Severe head pain with sudden onset, reaching its maximum intensity in less than one minute and lasting from one hour to ten days. Evidence: TAS. Frequency: Occasional (HP:0040283). (ORPHA:91355)
- Psychosis (HP:0000709): A condition characterized by changes in personality and thought patterns, often accompanied by hallucinations and delusional beliefs, is known as psychosis. Evidence: TAS. Frequency: Very rare (HP:0040284). (ORPHA:91355)
- Central diabetes insipidus (HP:0000863): A form of diabetes insipidus related to a failure of vasopressin (AVP) release from the hypothalamus. Evidence: TAS. Frequency: Very rare (HP:0040284). (ORPHA:91355)
- Coma (HP:0001259): The complete absence of wakefulness and consciousness, which is evident through a lack of response to any form of external stimuli. Evidence: TAS. Frequency: Very rare (HP:0040284). (ORPHA:91355)
- Panhypopituitarism (HP:0000871): A pituitary functional deficit affecting all the anterior pituitary hormones (growth hormone, thyroid-stimulating hormone, follicle-stimulating hormone, luteinizing hormone, adrenocorticotropic hormone, and prolactin). Evidence: TAS. Frequency: Very frequent (HP:0040281). (ORPHA:91355)
- Oligomenorrhea (HP:0000876): Infrequent menses (less than 6 per year or more than 35 days between cycles). Evidence: TAS. Frequency: Very frequent (HP:0040281). (ORPHA:91355)
- Decreased circulating cortisol level (HP:0008163): Abnormally reduced concentration of cortisol in the blood. Evidence: TAS. Frequency: Very frequent (HP:0040281). (ORPHA:91355)
- Secondary growth hormone deficiency (HP:0008240). Evidence: TAS. Frequency: Very frequent (HP:0040281). (ORPHA:91355)
- Adrenocorticotropin deficient adrenal insufficiency (HP:0011735): Adrenal insufficiency secondary to a defect in ACTH production. Evidence: TAS. Frequency: Very frequent (HP:0040281). (ORPHA:91355)
- Adrenocorticotropic hormone deficiency (HP:0011748): A reduced ability to secrete adrenocorticotropic hormone (ACTH), a hormone that stimulates the adrenal cortex to secrete of glucocorticoids such as cortisol. Evidence: TAS. Frequency: Very frequent (HP:0040281). (ORPHA:91355)
- Chronic fatigue (HP:0012432): Subjective feeling of tiredness characterized by a lack of energy and motivation that persists for six months or longer. Evidence: TAS. Frequency: Very frequent (HP:0040281). (ORPHA:91355)
- Amenorrhea (HP:0000141): Absence of menses for an interval of time equivalent to a total of more than (or equal to) 3 previous cycles or 6 months. Evidence: TAS. Frequency: Frequent (HP:0040282). (ORPHA:91355)
- Blurred vision (HP:0000622): Lack of sharpness of vision resulting in the inability to see fine detail. Evidence: TAS. Frequency: Frequent (HP:0040282). (ORPHA:91355)
- Impotence (HP:0000802): Inability to develop or maintain an erection of the penis. Evidence: TAS. Frequency: Frequent (HP:0040282). (ORPHA:91355)
- Dry skin (HP:0000958): Skin characterized by the lack of natural or normal moisture. Evidence: TAS. Frequency: Frequent (HP:0040282). (ORPHA:91355)
- Pallor (HP:0000980): Abnormally pale skin. Evidence: TAS. Frequency: Frequent (HP:0040282). (ORPHA:91355)
- Orthostatic hypotension (HP:0001278): A form of hypotension characterized by a sudden fall in blood pressure that occurs when a person assumes a standing position. Evidence: TAS. Frequency: Frequent (HP:0040282). (ORPHA:91355)
- Normochromic anemia (HP:0001895). Evidence: TAS. Frequency: Frequent (HP:0040282). (ORPHA:91355)
- Hypoglycemia (HP:0001943): A decreased concentration of glucose in the blood. Evidence: TAS. Frequency: Frequent (HP:0040282). (ORPHA:91355)
- Nausea (HP:0002018): A sensation of unease in the stomach together with an urge to vomit. Evidence: TAS. Frequency: Frequent (HP:0040282). (ORPHA:91355)
- Sparse axillary hair (HP:0002215): Reduced number or density of axillary hair. Evidence: TAS. Frequency: Frequent (HP:0040282). (ORPHA:91355)
- Sparse pubic hair (HP:0002225): Reduced number or density of pubic hair. Evidence: TAS. Frequency: Frequent (HP:0040282). (ORPHA:91355)
- Headache (HP:0002315): Cephalgia, or pain sensed in various parts of the head, not confined to the area of distribution of any nerve. Evidence: TAS. Frequency: Frequent (HP:0040282). (ORPHA:91355)
- Hyposthenuria (HP:0003158): An abnormally low urinary specific gravity, i.e., reduced concentration of solutes in the urine. Evidence: TAS. Frequency: Frequent (HP:0040282). (ORPHA:91355)
- Breast hypoplasia (HP:0003187): Underdevelopment of the breast. Evidence: TAS. Frequency: Frequent (HP:0040282). (ORPHA:91355)
- Progressive visual field defects (HP:0007987). Evidence: TAS. Frequency: Frequent (HP:0040282). (ORPHA:91355)
- Reduced circulating prolactin concentration (HP:0008202): A reduced level of prolactin in the blood circulation. Prolactin is a protein hormone that is secreted by lactotrophs in the anterior pituitary and that stimulates mammary gland development and milk production. Evidence: TAS. Frequency: Frequent (HP:0040282). (ORPHA:91355)
- Gonadotropin deficiency (HP:0008213): A reduced ability to secrete gonadotropins, which are protein hormones secreted by gonadotrope cells of the anterior pituitary gland, including the hormones follitropin (FSH) and luteinizing hormone (LH). Evidence: TAS. Frequency: Frequent (HP:0040282). (ORPHA:91355)
- Decreased serum estradiol (HP:0008214): A reduction below normal concentration of estradiol in the circulation. Evidence: TAS. Frequency: Frequent (HP:0040282). (ORPHA:91355)
- Pituitary hypothyroidism (HP:0008245): A type of hypothyroidism that results from a defect in thyroid-stimulating hormone secretion. Evidence: TAS. Frequency: Frequent (HP:0040282). (ORPHA:91355)
- Central adrenal insufficiency (HP:0011734): A form of adrenal insufficiency related to a lack of ACTH, which leads to a decrease in the production of cortisol by the adrenal glands. Aldosterone production is not usually affected. Evidence: TAS. Frequency: Frequent (HP:0040282). (ORPHA:91355)
- Abnormal size of pituitary gland (HP:0012504): A deviation from the normal size of the pituitary gland. Evidence: TAS. Frequency: Frequent (HP:0040282). (ORPHA:91355)